- Metabolic acidosis (HP:0001942): Metabolic acidosis (MA) is characterized by a fall in blood pH due to a reduction of serum bicarbonate concentration. This can occur as a result of either the accumulation of acids (high anion gap MA) or the loss of bicarbonate from the gastrointestinal tract or the kidney (hyperchloremic MA). By definition, MA is not due to a respirary cause. Evidence: TAS. Frequency: Very frequent (HP:0040281). (ORPHA:31826)
- Lactic acidosis (HP:0003128): An abnormal buildup of lactic acid in the body, leading to acidification of the blood and other bodily fluids. Evidence: TAS. Frequency: Very frequent (HP:0040281). (ORPHA:31826)
- Ataxia (HP:0001251): Ataxia refers to impaired coordination of voluntary muscle movement. Cerebellar ataxia refers to ataxia due to dysfunction of the cerebellum. This causes a variety of elementary neurological deficits including asynergy (lack of coordination between muscles, limbs and joints), dysmetria (lack of ability to judge distances that can lead to under- or overshoot in grasping movements), and dysdiadochokinesia (inability to perform rapid movements requiring antagonizing muscle groups to be switched on and off repeatedly). Evidence: TAS. Frequency: Frequent (HP:0040282). (ORPHA:31826)
- Confusion (HP:0001289): Lack of clarity and coherence of thought, perception, understanding, or action. Evidence: TAS. Frequency: Frequent (HP:0040282). (ORPHA:31826)
- Slurred speech (HP:0001350): Abnormal coordination of muscles involved in speech. Evidence: TAS. Frequency: Frequent (HP:0040282). (ORPHA:31826)
- Tachycardia (HP:0001649): A rapid heartrate that exceeds the range of the normal resting heartrate for age. Evidence: TAS. Frequency: Frequent (HP:0040282). (ORPHA:31826)
- Vomiting (HP:0002013): Forceful ejection of the contents of the stomach through the mouth by means of a series of involuntary spasmic contractions. Evidence: TAS. Frequency: Frequent (HP:0040282). (ORPHA:31826)
- Nausea (HP:0002018): A sensation of unease in the stomach together with an urge to vomit. Evidence: TAS. Frequency: Frequent (HP:0040282). (ORPHA:31826)
- Drowsiness (HP:0002329): Abnormal feeling of sleepiness or difficulty staying awake. Evidence: TAS. Frequency: Frequent (HP:0040282). (ORPHA:31826)
- Tachypnea (HP:0002789): Very rapid breathing. Evidence: TAS. Frequency: Frequent (HP:0040282). (ORPHA:31826)
- Hypocalcemia (HP:0002901): The concentration of calcium in the blood circulation is below the lower limit of normal. Evidence: TAS. Frequency: Frequent (HP:0040282). (ORPHA:31826)
- Euphoria (HP:0031844): Elevation of emotional tone or mood that significantly deviates from normative affective functioning. This state is characterized by an overwhelming and all-encompassing sense of joyous well-being; it is associated with unfounded grandiosity, or grossly inflated self-esteem, rapid speech, impulsivity, and an impaired capacity for self-regulation, irrespective of context. Evidence: TAS. Frequency: Frequent (HP:0040282). (ORPHA:31826)
- Elevated serum anion gap (HP:0031962): An abnormally high value of the serum anion gap (the sum of serum chloride and bicarbonate concentrations subtracted from the serum sodium concentration). Evidence: TAS. Frequency: Frequent (HP:0040282). (ORPHA:31826)
- Renal insufficiency (HP:0000083): A reduction in the level of performance of the kidneys in areas of function comprising the concentration of urine, removal of wastes, the maintenance of electrolyte balance, homeostasis of blood pressure, and calcium metabolism. Evidence: TAS. Frequency: Occasional (HP:0040283). (ORPHA:31826)
- Hypertension (HP:0000822): The presence of chronic increased pressure in the systemic arterial system. Evidence: TAS. Frequency: Occasional (HP:0040283). (ORPHA:31826)
- Cyanosis (HP:0000961): Bluish discoloration of the skin and mucosa due to poor circulation or inadequate oxygenation of arterial or capillary blood. Evidence: TAS. Frequency: Occasional (HP:0040283). (ORPHA:31826)
- Coma (HP:0001259): The complete absence of wakefulness and consciousness, which is evident through a lack of response to any form of external stimuli. Evidence: TAS. Frequency: Occasional (HP:0040283). (ORPHA:31826)
- Congestive heart failure (HP:0001635): The presence of an abnormality of cardiac function that is responsible for the failure of the heart to pump blood at a rate that is commensurate with the needs of the tissues or a state in which abnormally elevated filling pressures are required for the heart to do so. Heart failure is frequently related to a defect in myocardial contraction. Evidence: TAS. Frequency: Occasional (HP:0040283). (ORPHA:31826)
- Prolonged QT interval (HP:0001657): Increased time between the start of the Q wave and the end of the T wave as measured by the electrocardiogram (EKG). Evidence: TAS. Frequency: Occasional (HP:0040283). (ORPHA:31826)
- Hyperkalemia (HP:0002153): The concentration of potassium(1+) in the blood circulation is above the upper limit of normal. Evidence: TAS. Frequency: Occasional (HP:0040283). (ORPHA:31826)
- Headache (HP:0002315): Cephalgia, or pain sensed in various parts of the head, not confined to the area of distribution of any nerve. Evidence: TAS. Frequency: Occasional (HP:0040283). (ORPHA:31826)
- Hypotension (HP:0002615): Low Blood Pressure, vascular hypotension. Evidence: TAS. Frequency: Occasional (HP:0040283). (ORPHA:31826)
- Abnormal pattern of respiration (HP:0002793): An anomaly of the rhythm or depth of breathing. Evidence: TAS. Frequency: Occasional (HP:0040283). (ORPHA:31826)
- Episodic respiratory distress (HP:0004885). Evidence: TAS. Frequency: Occasional (HP:0040283). (ORPHA:31826)
- Atrial fibrillation (HP:0005110): An atrial arrhythmia characterized by disorganized atrial activity without discrete P waves on the surface EKG, but instead by an undulating baseline or more sharply circumscribed atrial deflections of varying amplitude an frequency ranging from 350 to 600 per minute. Evidence: TAS. Frequency: Occasional (HP:0040283). (ORPHA:31826)
- Gastritis (HP:0005263): The presence of inflammation of the gastric mucous membrane. Evidence: TAS. Frequency: Occasional (HP:0040283). (ORPHA:31826)
- Abnormal pupillary light reflex (HP:0007695): An abnormality of the reflex that controls the diameter of the pupil, in response to the intensity of light that falls on the retina of the eye. Evidence: TAS. Frequency: Occasional (HP:0040283). (ORPHA:31826)
- Addictive alcohol use (HP:0030955): An addictive behavior is defined as drinking excessive amounts of alcohol over a prolonged period of time, having difficulty in reducing the amount of alcohol consumed, strongly desiring alcohol, and experiencing withdrawal symptoms when not drinking alcohol. Evidence: TAS. Frequency: Occasional (HP:0040283). (ORPHA:31826)
- Shock (HP:0031273): The state in which profound and widespread reduction of effective tissue perfusion leads first to reversible, and then if prolonged, to irreversible cellular injury. Evidence: TAS. Frequency: Occasional (HP:0040283). (ORPHA:31826)
- Pulmonary edema (HP:0100598): Fluid accumulation in the lungs. Evidence: TAS. Frequency: Occasional (HP:0040283). (ORPHA:31826)
- Renal tubular dysfunction (HP:0000124): Abnormal function of the renal tubule. The basic functional unit of the kidney, the nephron, consists of a renal corpuscle attached to a renal tubule, with roughly 0.8 to 1.5 nephrons per adult kidney. The functions of the renal tubule include reabsorption of water, electrolytes, glucose, and amino acids and secretion of substances such as uric acid. Evidence: TAS. Frequency: Very rare (HP:0040284). (ORPHA:31826)
- Ophthalmoplegia (HP:0000602): Paralysis of one or more extraocular muscles that are responsible for eye movements. Evidence: TAS. Frequency: Very rare (HP:0040284). (ORPHA:31826)
- Nystagmus (HP:0000639): Rhythmic, involuntary oscillations of one or both eyes related to abnormality in fixation, conjugate gaze, or vestibular mechanisms. Evidence: TAS. Frequency: Very rare (HP:0040284). (ORPHA:31826)
- Hematuria (HP:0000790): The presence of blood in the urine. Hematuria may be gross hematuria (visible to the naked eye) or microscopic hematuria (detected by dipstick or microscopic examination of the urine). Evidence: TAS. Frequency: Very rare (HP:0040284). (ORPHA:31826)
- Seizure (HP:0001250): A seizure is an intermittent abnormality of nervous system physiology characterized by a transient occurrence of signs and/or symptoms due to abnormal excessive or synchronous neuronal activity in the brain. Evidence: TAS. Frequency: Very rare (HP:0040284). (ORPHA:31826)
- Encephalopathy (HP:0001298): Encephalopathy is a term that means brain disease, damage, or malfunction. In general, encephalopathy is manifested by an altered mental state. Evidence: TAS. Frequency: Very rare (HP:0040284). (ORPHA:31826)
- Myoclonus (HP:0001336): Very brief, involuntary random muscular contractions occurring at rest, in response to sensory stimuli, or accompanying voluntary movements. Evidence: TAS. Frequency: Very rare (HP:0040284). (ORPHA:31826)
- Hypothermia (HP:0002045): Reduced body temperature due to failed thermoregulation. Evidence: TAS. Frequency: Very rare (HP:0040284). (ORPHA:31826)
- Cerebral edema (HP:0002181): Abnormal accumulation of fluid in the brain. Evidence: TAS. Frequency: Very rare (HP:0040284). (ORPHA:31826)
- Renal tubular epithelial necrosis (HP:0008682): Coagulative necrosis of tubular epithelial cells, defined as cells with increased cytoplasmic eosinophilia and nucleus that has a condensed chromatin pattern with fuzzy nuclear contour or has barely visible nuclear basophilic staining. The extent of cortical tubular necrosis is scoredsemiquantitatively as none, mild (less than 25% tubules with necrosis), moderate (25-50 percent), and severe (over 50%). Evidence: TAS. Frequency: Very rare (HP:0040284). (ORPHA:31826)
- Facial palsy (HP:0010628): Facial nerve palsy is a dysfunction of cranial nerve VII (the facial nerve) that results in inability to control facial muscles on the affected side with weakness of the muscles of facial expression and eye closure. This can either be present in unilateral or bilateral form. Evidence: TAS. Frequency: Very rare (HP:0040284). (ORPHA:31826)
- Decreased urine output (HP:0011037): A decreased rate of urine production. Evidence: TAS. Frequency: Very rare (HP:0040284). (ORPHA:31826)
- Flank pain (HP:0030157): An unpleasant sensation characterized by physical discomfort (such as pricking, throbbing, or aching) and perceived to originate in the flank. Evidence: TAS. Frequency: Very rare (HP:0040284). (ORPHA:31826)
- Abnormal cranial nerve physiology (HP:0031910): A functional abnormality affecting one or more of the cranial nerves, which emerge directly from the brain stem. Evidence: TAS. Frequency: Very rare (HP:0040284). (ORPHA:31826)
These phenotypes are associated with the disease Ethylene glycol poisoning (ORPHA:31826).